Phenotypes associated with the disease Amobarbital, deficient N-hydroxylation of (OMIM:204800):
- Abnormality of metabolism/homeostasis (HP:0001939). Evidence: IEA. (OMIM:204800)
- Autosomal recessive inheritance (HP:0000007): A mode of inheritance that is observed for traits related to a gene encoded on one of the autosomes (i.e., the human chromosomes 1-22) in which a trait manifests in individuals with two pathogenic alleles, either homozygotes (two copies of the same mutant allele) or compound heterozygotes (whereby each copy of a gene has a distinct mutant allele). Evidence: IEA. (OMIM:204800)